Phenotypes associated with the disease Macrocephaly-intellectual disability-left ventricular non compaction syndrome (ORPHA:466791):
- Relative macrocephaly (HP:0004482): A relatively mild degree of macrocephaly in which the head circumference is not above two standard deviations from the mean, but appears dysproportionately large when other factors such as body stature are taken into account. Evidence: TAS. Frequency: Very frequent (HP:0040281). (ORPHA:466791)
- Open mouth (HP:0000194): A facial appearance characterized by a permanently or nearly permanently opened mouth. Evidence: TAS. Frequency: Frequent (HP:0040282). (ORPHA:466791)
- Malar flattening (HP:0000272): Underdevelopment of the malar prominence of the jugal bone (zygomatic bone in mammals), appreciated in profile, frontal view, and/or by palpation. Evidence: TAS. Frequency: Frequent (HP:0040282). (ORPHA:466791)
- Long face (HP:0000276): Facial height (length) is more than 2 standard deviations above the mean (objective); or, an apparent increase in the height (length) of the face (subjective). Evidence: TAS. Frequency: Frequent (HP:0040282). (ORPHA:466791)
- Prominent nasal bridge (HP:0000426): Anterior positioning of the nasal root in comparison to the usual positioning for age. Evidence: TAS. Frequency: Frequent (HP:0040282). (ORPHA:466791)
- Narrow nasal bridge (HP:0000446): Decreased width of the bony bridge of the nose. Evidence: TAS. Frequency: Frequent (HP:0040282). (ORPHA:466791)
- Prominent nose (HP:0000448): Distance between subnasale and pronasale more than two standard deviations above the mean, or alternatively, an apparently increased anterior protrusion of the nasal tip. Evidence: TAS. Frequency: Frequent (HP:0040282). (ORPHA:466791)
- Strabismus (HP:0000486): A misalignment of the eyes so that the visual axes deviate from bifoveal fixation. The classification of strabismus may be based on a number of features including the relative position of the eyes, whether the deviation is latent or manifest, intermittent or constant, concomitant or otherwise and according to the age of onset and the relevance of any associated refractive error. Evidence: TAS. Frequency: Frequent (HP:0040282). (ORPHA:466791)
- Myopia (HP:0000545): An abnormality of refraction characterized by the ability to see objects nearby clearly, while objects in the distance appear blurry. Evidence: TAS. Frequency: Frequent (HP:0040282). (ORPHA:466791)
- Upslanted palpebral fissure (HP:0000582): The palpebral fissure inclination is more than two standard deviations above the mean for age (objective); or, the inclination of the palpebral fissure is greater than typical for age. Evidence: TAS. Frequency: Frequent (HP:0040282). (ORPHA:466791)
- Dental crowding (HP:0000678): Changes in alignment of teeth in the dental arch. Evidence: TAS. Frequency: Frequent (HP:0040282). (ORPHA:466791)
- Anxiety (HP:0000739): Intense feelings of nervousness, tension, or panic often arise in response to interpersonal stresses. There is worry about the negative effects of past unpleasant experiences and future negative possibilities. Individuals may feel fearful, apprehensive, or threatened by uncertainty, and they may also have fears of falling apart or losing control. Evidence: TAS. Frequency: Frequent (HP:0040282). (ORPHA:466791)
- Delayed speech and language development (HP:0000750): A degree of language development that is significantly below the norm for a child of a specified age. Evidence: TAS. Frequency: Frequent (HP:0040282). (ORPHA:466791)
- Mild intellectual disability (HP:0001256): Mild intellectual disability (ID) is defined as a type of ID characterized by mildly sub-average adaptive functioning and intellectual functioning, with an intelligence quotient (IQ) the range of 50-69. Evidence: TAS. Frequency: Frequent (HP:0040282). (ORPHA:466791)
- Generalized hypotonia (HP:0001290): Generalized muscular hypotonia (abnormally low muscle tone). Evidence: TAS. Frequency: Frequent (HP:0040282). (ORPHA:466791)
- Slender build (HP:0001533): Asthenic habitus refers to a slender build with long limbs, an angular profile, and prominent muscles or bones. Evidence: TAS. Frequency: Frequent (HP:0040282). (ORPHA:466791)
- Hypernasal speech (HP:0001611): A type of speech characterized by the presence of an abnormally increased nasal airflow during speech associated with structural abnormality of the nasal passages. Evidence: TAS. Frequency: Frequent (HP:0040282). (ORPHA:466791)
- Abnormal left ventricle morphology (HP:0001711): Any structural abnormality of the left ventricle of the heart. Evidence: TAS. Frequency: Frequent (HP:0040282). (ORPHA:466791)
- Pes planus (HP:0001763): A foot where the longitudinal arch of the foot is in contact with the ground or floor when the individual is standing; or, in a patient lying supine, a foot where the arch is in contact with the surface of a flat board pressed against the sole of the foot by the examiner with a pressure similar to that expected from weight bearing; or, the height of the arch is reduced. Evidence: TAS. Frequency: Frequent (HP:0040282). (ORPHA:466791)
- Abnormal facial shape (HP:0001999): An abnormal morphology (form) of the face or its components. Evidence: TAS. Frequency: Frequent (HP:0040282). (ORPHA:466791)
- Poor suck (HP:0002033): An inadequate sucking reflex, resulting in the difficult of newborns to be breast-fed. Evidence: TAS. Frequency: Frequent (HP:0040282). (ORPHA:466791)
- Delayed gross motor development (HP:0002194): A type of motor delay characterized by a delay in acquiring the ability to control the large muscles of the body for walking, running, sitting, and crawling. Evidence: TAS. Frequency: Frequent (HP:0040282). (ORPHA:466791)
- Poor head control (HP:0002421): Difficulty to maintain correct position of the head while standing or sitting. Infant head lag is observed when the head seems to flop around or lags posteriorly behind the trunk. Several articles have maintained that head lag should be absent by age 3 to 4 months. Evidence: TAS. Frequency: Frequent (HP:0040282). (ORPHA:466791)
- High, narrow palate (HP:0002705): The presence of a high and narrow palate. Evidence: TAS. Frequency: Frequent (HP:0040282). (ORPHA:466791)
- Kyphoscoliosis (HP:0002751): An abnormal curvature of the spine in both a coronal (lateral) and sagittal (back-to-front) plane. Evidence: TAS. Frequency: Frequent (HP:0040282). (ORPHA:466791)
- Dysplastic corpus callosum (HP:0006989): Dysplasia and dysgenesis of the corpus callosum are nonspecific descriptions that imply defective development of the corpus callosum. The term dysplasia is applied when the morphology of the corpus callosum is altered as a congenital trait. For instance, the corpus callosum may be hump-shaped, kinked, or a striped corpus callosum that lacks an anatomically distinct genu and splenium. Evidence: TAS. Frequency: Frequent (HP:0040282). (ORPHA:466791)
- Synostosis involving the 1st metacarpal (HP:0009703): Fusion of the 1st metacarpal with another bone. In contrast to the proximal phalanges of the digits 2 to 5, the proximal phalanx of the thumb is embryologically equivalent to the middle phalanges of the other digits, whereas the first metacarpal is embryologically of phalangeal origin and as such equivalent to the proximal phalanges of the other digits. Evidence: TAS. Frequency: Frequent (HP:0040282). (ORPHA:466791)
- Feeding difficulties (HP:0011968): Impaired ability to eat related to problems gathering food and getting ready to suck, chew, or swallow it. Evidence: TAS. Frequency: Frequent (HP:0040282). (ORPHA:466791)
- Excessive shyness (HP:0100962): Atypically high degree of awkwardness or apprehension experienced when approaching or being approached by others. Evidence: TAS. Frequency: Frequent (HP:0040282). (ORPHA:466791)
- Cryptorchidism (HP:0000028): Testis in inguinal canal. That is, absence of one or both testes from the scrotum owing to failure of the testis or testes to descend through the inguinal canal to the scrotum. Evidence: TAS. Frequency: Occasional (HP:0040283). (ORPHA:466791)
- Wide mouth (HP:0000154): Distance between the oral commissures more than 2 SD above the mean. Alternatively, an apparently increased width of the oral aperture (subjective). Evidence: TAS. Frequency: Occasional (HP:0040283). (ORPHA:466791)
- Thin upper lip vermilion (HP:0000219): Height of the vermilion of the upper lip in the midline more than 2 SD below the mean. Alternatively, an apparently reduced height of the vermilion of the upper lip in the frontal view (subjective). Evidence: TAS. Frequency: Occasional (HP:0040283). (ORPHA:466791)
- Epicanthus (HP:0000286): A fold of skin starting above the medial aspect of the upper eyelid and arching downward to cover, pass in front of and lateral to the medial canthus. Evidence: TAS. Frequency: Occasional (HP:0040283). (ORPHA:466791)
- Hypertelorism (HP:0000316): Interpupillary distance more than 2 SD above the mean (alternatively, the appearance of an increased interpupillary distance or widely spaced eyes). Evidence: TAS. Frequency: Occasional (HP:0040283). (ORPHA:466791)
- Short philtrum (HP:0000322): Distance between nasal base and midline upper lip vermilion border more than 2 SD below the mean. Alternatively, an apparently decreased distance between nasal base and midline upper lip vermilion border. Evidence: TAS. Frequency: Occasional (HP:0040283). (ORPHA:466791)
- Triangular face (HP:0000325): Facial contour, as viewed from the front, triangular in shape, with breadth at the temples and tapering to a narrow chin. Evidence: TAS. Frequency: Occasional (HP:0040283). (ORPHA:466791)
- Downslanted palpebral fissures (HP:0000494): The palpebral fissure inclination is more than two standard deviations below the mean. Evidence: TAS. Frequency: Occasional (HP:0040283). (ORPHA:466791)
- Widely spaced teeth (HP:0000687): Increased spaces (diastemata) between most of the teeth in the same dental arch. Evidence: TAS. Frequency: Occasional (HP:0040283). (ORPHA:466791)
- Autism (HP:0000717): Autism is a neurodevelopmental disorder characterized by impaired social interaction and communication, and by restricted and repetitive behavior. Autism begins in childhood. It is marked by the presence of markedly abnormal or impaired development in social interaction and communication and a markedly restricted repertoire of activity and interest. Manifestations of the disorder vary greatly depending on the developmental level and chronological age of the individual (DSM-IV). Evidence: TAS. Frequency: Occasional (HP:0040283). (ORPHA:466791)
- Aggressive behavior (HP:0000718): Behavior or an act aimed at harming a person, animal, or physical property (e.g., acts of physical violence; shouting, swearing, and using harsh language; slashing someone's tires). Evidence: TAS. Frequency: Occasional (HP:0040283). (ORPHA:466791)
- Delayed puberty (HP:0000823): Passing the age when puberty normally occurs with no physical or hormonal signs of the onset of puberty. Evidence: TAS. Frequency: Occasional (HP:0040283). (ORPHA:466791)
- Seizure (HP:0001250): A seizure is an intermittent abnormality of nervous system physiology characterized by a transient occurrence of signs and/or symptoms due to abnormal excessive or synchronous neuronal activity in the brain. Evidence: TAS. Frequency: Occasional (HP:0040283). (ORPHA:466791)
- Ataxia (HP:0001251): Ataxia refers to impaired coordination of voluntary muscle movement. Cerebellar ataxia refers to ataxia due to dysfunction of the cerebellum. This causes a variety of elementary neurological deficits including asynergy (lack of coordination between muscles, limbs and joints), dysmetria (lack of ability to judge distances that can lead to under- or overshoot in grasping movements), and dysdiadochokinesia (inability to perform rapid movements requiring antagonizing muscle groups to be switched on and off repeatedly). Evidence: TAS. Frequency: Occasional (HP:0040283). (ORPHA:466791)
- Cerebellar hypoplasia (HP:0001321): Cerebellar hypoplasia is a descriptive term implying a cerebellum with a reduced volume, but a normal shape and is stable over time. Evidence: TAS. Frequency: Occasional (HP:0040283). (ORPHA:466791)
- Plagiocephaly (HP:0001357): Asymmetric head shape, which is usually a combination of unilateral occipital flattening with ipsilateral frontal prominence, leading to rhomboid cranial shape. Evidence: TAS. Frequency: Occasional (HP:0040283). (ORPHA:466791)
- Joint hypermobility (HP:0001382): The capability that a joint (or a group of joints) has to move, passively and/or actively, beyond normal limits along physiological axes. Evidence: TAS. Frequency: Occasional (HP:0040283). (ORPHA:466791)
- Failure to thrive (HP:0001508): Failure to thrive (FTT) refers to a child whose physical growth is substantially below the norm. Evidence: TAS. Frequency: Occasional (HP:0040283). (ORPHA:466791)
- Ventricular septal defect (HP:0001629): A hole between the two bottom chambers (ventricles) of the heart. The defect is centered around the most superior aspect of the ventricular septum. Evidence: TAS. Frequency: Occasional (HP:0040283). (ORPHA:466791)
- Atrial septal defect (HP:0001631): Atrial septal defect (ASD) is a congenital abnormality of the interatrial septum that enables blood flow between the left and right atria via the interatrial septum. Evidence: TAS. Frequency: Occasional (HP:0040283). (ORPHA:466791)
- Patent ductus arteriosus (HP:0001643): In utero, the ductus arteriosus (DA) serves to divert ventricular output away from the lungs and toward the placenta by connecting the main pulmonary artery to the descending aorta. A patent ductus arteriosus (PDA) in the first 3 days of life is a physiologic shunt in healthy term and preterm newborn infants, and normally is substantially closed within about 24 hours after bith and completely closed after about three weeks. Failure of physiologcal closure is referred to a persistent or patent ductus arteriosus (PDA). Depending on the degree of left-to-right shunting, PDA can have clinical consequences. Evidence: TAS. Frequency: Occasional (HP:0040283). (ORPHA:466791)
- Patent foramen ovale (HP:0001655): Failure of the foramen ovale to seal postnatally, leaving a potential conduit between the left and right cardiac atria. Evidence: TAS. Frequency: Occasional (HP:0040283). (ORPHA:466791)
- Right ventricular hypertrophy (HP:0001667): In this case the right ventricle is more muscular than normal, causing a characteristic boot-shaped (coeur-en-sabot) appearance as seen on anterior- posterior chest x-rays. Right ventricular hypertrophy is commonly associated with any form of right ventricular outflow obstruction or pulmonary hypertension, which may in turn owe its origin to left-sided disease. The echocardiographic signs are thickening of the anterior right ventricular wall and the septum. Cavity size is usually normal, or slightly enlarged. In many cases there is associated volume overload present due to tricuspid regurgitation, in the absence of this, septal motion is normal. Evidence: TAS. Frequency: Occasional (HP:0040283). (ORPHA:466791)
- Left ventricular hypertrophy (HP:0001712): Enlargement or increased size of the heart left ventricle. Evidence: TAS. Frequency: Occasional (HP:0040283). (ORPHA:466791)
- Hallux valgus (HP:0001822): Lateral deviation of the great toe (i.e., in the direction of the little toe). Evidence: TAS. Frequency: Occasional (HP:0040283). (ORPHA:466791)
- Frontal bossing (HP:0002007): Bilateral bulging of the lateral frontal bone prominences with relative sparing of the midline. Evidence: TAS. Frequency: Occasional (HP:0040283). (ORPHA:466791)
- Gastroesophageal reflux (HP:0002020): A condition in which the stomach contents leak backwards from the stomach into the esophagus through the lower esophageal sphincter. Evidence: TAS. Frequency: Occasional (HP:0040283). (ORPHA:466791)
- Hypoplasia of the corpus callosum (HP:0002079): Underdevelopment of the corpus callosum. Evidence: TAS. Frequency: Occasional (HP:0040283). (ORPHA:466791)
- Intention tremor (HP:0002080): A type of kinetic tremor that occurs during target directed movement is called intention tremor. That is, an oscillatory cerebellar ataxia that tends to be absent when the limbs are inactive and during the first part of voluntary movement but worsening as the movement continues and greater precision is required (e.g., in touching a target such as the patient's nose or a physician's finger). Evidence: TAS. Frequency: Occasional (HP:0040283). (ORPHA:466791)
- Poor speech (HP:0002465). Evidence: TAS. Frequency: Occasional (HP:0040283). (ORPHA:466791)
- Supernumerary nipple (HP:0002558): Presence of more than two nipples. Evidence: TAS. Frequency: Occasional (HP:0040283). (ORPHA:466791)
- Thickened calvaria (HP:0002684): The presence of an abnormally thick calvaria. Evidence: TAS. Frequency: Occasional (HP:0040283). (ORPHA:466791)
- Obstructive sleep apnea (HP:0002870): Obstructive Sleep Apnea is a condition characterized by the obstruction of the airway and pauses in breathing during sleep, which occur multiple times throughout the night. It is related to the relaxation of muscle tone that typically happens during sleep, leading to a partial collapse of the soft tissues in the airway and causing airflow obstruction. Evidence: TAS. Frequency: Occasional (HP:0040283). (ORPHA:466791)
- Clinodactyly of the 5th finger (HP:0004209): Clinodactyly refers to a bending or curvature of the fifth finger in the radial direction (i.e., towards the 4th finger). Evidence: TAS. Frequency: Occasional (HP:0040283). (ORPHA:466791)
- Talipes valgus (HP:0004684): Outward turning of the heel, resulting in clubfoot with the person walking on the inner part of the foot. Evidence: TAS. Frequency: Occasional (HP:0040283). (ORPHA:466791)
- Tricuspid regurgitation (HP:0005180): Failure of the tricuspid valve to close sufficiently upon contraction of the right ventricle, causing blood to regurgitate (flow backward) into the right atrium. Evidence: TAS. Frequency: Occasional (HP:0040283). (ORPHA:466791)
- Pseudobulbar paralysis (HP:0007024): Bilateral impairment of the function of the cranial nerves 9-12, which control musculature involved in eating, swallowing, and speech. Pseudobulbar paralysis is characterized clinically by dysarthria, dysphonia, and dysphagia with bifacial paralysis, and may be accompanied by Pseudobulbar behavioral symptoms such as enforced crying and laughing. Evidence: TAS. Frequency: Occasional (HP:0040283). (ORPHA:466791)
- Hyperactive patellar reflex (HP:0007083). Evidence: TAS. Frequency: Occasional (HP:0040283). (ORPHA:466791)
- Chiari type I malformation (HP:0007099): Arnold-Chiari type I malformation refers to a relatively mild degree of herniation of the posteroinferior region of the cerebellum (the cerebellar tonsils) into the cervical canal with little or no displacement of the fourth ventricle. It is characterized by one or both pointed (not rounded) cerebellar tonsils that project 5 mm below the foramen magnum, measured by a line drawn from the basion to the opisthion (McRae Line). Evidence: TAS. Frequency: Occasional (HP:0040283). (ORPHA:466791)
- Confetti-like hypopigmented macules (HP:0007449). Evidence: TAS. Frequency: Occasional (HP:0040283). (ORPHA:466791)
- Bilateral cryptorchidism (HP:0008689): Absence of both testes from the scrotum owing to failure of the testis or testes to descend through the inguinal canal to the scrotum. Evidence: TAS. Frequency: Occasional (HP:0040283). (ORPHA:466791)
- Ebstein anomaly of the tricuspid valve (HP:0010316): Ebstein's anomaly refers to an abnormally placed and deformed tricuspid valve characterized by apical displacement of the septal and posterior tricuspid valve leaflets, leading to atrialization of the right ventricle with a variable degree of malformation and displacement of the anterior leaflet. Evidence: TAS. Frequency: Occasional (HP:0040283). (ORPHA:466791)
- Anterior pituitary hypoplasia (HP:0010627): Underdevelopment of the anterior pituitary gland. Evidence: TAS. Frequency: Occasional (HP:0040283). (ORPHA:466791)
- Speech apraxia (HP:0011098): A type of apraxia that is characterized by difficulty or inability to execute speech movements because of problems with coordination and motor problems, leading to incorrect articulation. An increase of errors with increasing word and phrase length may occur. Evidence: TAS. Frequency: Occasional (HP:0040283). (ORPHA:466791)
- Thick vermilion border (HP:0012471): Increased width of the skin of vermilion border region of upper lip. Evidence: TAS. Frequency: Occasional (HP:0040283). (ORPHA:466791)
- Abnormal cardiac ventricular function (HP:0030872): An abnormality of the cardiac ventricular function. Evidence: TAS. Frequency: Occasional (HP:0040283). (ORPHA:466791)
- Infantile constant exotropia (HP:0032009): Constant exotropia occurring before 6 months of age.; often associated with a large angle of deviation and ocular/CNS abnormalities. Evidence: TAS. Frequency: Occasional (HP:0040283). (ORPHA:466791)
- Nasogastric tube feeding (HP:0040288): The condition of inability to eat normally treated by placement of a thin tube through the nose into the stomach that is then used to carry food. Evidence: TAS. Frequency: Occasional (HP:0040283). (ORPHA:466791)